Phenotypes associated with the disease #612271 SKIN/HAIR/EYE PIGMENTATION, VARIATION IN, 11; SHEP11;;MELANESIAN BLOND HAIR;;SKIN/HAIR/EYE PIGMENTATION 11, BLUE/NONBLUE EYES (OMIM:612271):
- Abnormal skin pigmentation (HP:0001000): An abnormality of the pigmentation of the skin. Evidence: IEA. (OMIM:612271)
- Abnormal iris pigmentation (HP:0008034): Abnormal pigmentation of the iris. Evidence: IEA. (OMIM:612271)
- Blue irides (HP:0000635): A markedly blue coloration of the iris. Evidence: TAS. (OMIM:612271)
- Abnormality of hair pigmentation (HP:0009887): An abnormality of hair pigmentation (color). Evidence: IEA. (OMIM:612271)